Phenotypes associated with the disease autosomal recessive nonsyndromic hearing loss 24 (OMIM:611022):
- Infantile onset (HP:0003593): Onset of signs or symptoms of disease between 28 days to one year of life. Evidence: TAS. (OMIM:611022)
- Autosomal recessive inheritance (HP:0000007): A mode of inheritance that is observed for traits related to a gene encoded on one of the autosomes (i.e., the human chromosomes 1-22) in which a trait manifests in individuals with two pathogenic alleles, either homozygotes (two copies of the same mutant allele) or compound heterozygotes (whereby each copy of a gene has a distinct mutant allele). Evidence: TAS. (OMIM:611022)
- Profound sensorineural hearing impairment (HP:0011476): Complete loss of hearing related to a sensorineural defect. Evidence: TAS. (OMIM:611022)